Phenotypes associated with the disease hearing loss, autosomal recessive 120 (OMIM:620238):
- Congenital onset (HP:0003577): A phenotypic abnormality that is present at birth. Evidence: PCS. Frequency: 11/11. (PMID:35727972)
- Sensorineural hearing impairment (HP:0000407): A type of hearing impairment in one or both ears related to an abnormal functionality of the cochlear nerve. Evidence: PCS. Frequency: 11/11. (PMID:35727972)
- Autosomal recessive inheritance (HP:0000007): A mode of inheritance that is observed for traits related to a gene encoded on one of the autosomes (i.e., the human chromosomes 1-22) in which a trait manifests in individuals with two pathogenic alleles, either homozygotes (two copies of the same mutant allele) or compound heterozygotes (whereby each copy of a gene has a distinct mutant allele). Evidence: PCS. (PMID:35727972)